- Seizure (HP:0001250): A seizure is an intermittent abnormality of nervous system physiology characterized by a transient occurrence of signs and/or symptoms due to abnormal excessive or synchronous neuronal activity in the brain. Evidence: IEA. (OMIM:238340)
- Failure to thrive (HP:0001508): Failure to thrive (FTT) refers to a child whose physical growth is substantially below the norm. Evidence: IEA. (OMIM:238340)
- Sensorineural hearing impairment (HP:0000407): A type of hearing impairment in one or both ears related to an abnormal functionality of the cochlear nerve. Evidence: IEA. (OMIM:238340)
- Abnormality of metabolism/homeostasis (HP:0001939). Evidence: IEA. (OMIM:238340)
- Autosomal recessive inheritance (HP:0000007): A mode of inheritance that is observed for traits related to a gene encoded on one of the autosomes (i.e., the human chromosomes 1-22) in which a trait manifests in individuals with two pathogenic alleles, either homozygotes (two copies of the same mutant allele) or compound heterozygotes (whereby each copy of a gene has a distinct mutant allele). Evidence: IEA. (OMIM:238340)
- Retinal degeneration (HP:0000546): A nonspecific term denoting progressive loss of the retinal pigment epithelium (RPE) and/or neurosensory retinal cells. Evidence: IEA. (OMIM:238340)
- Intellectual disability (HP:0001249): The term intellectual disability or intellectual developmental disorder is used to describe significantly sub-average intellectual and adaptive functioning based on clinical assessment and as measured by individually administered, appropriately normed, standardized and validated tests of intellectual functioning and adaptive behavior, with onset during the developmental period from infancy through adolescence. Evidence: IEA. (OMIM:238340)
These phenotypes are associated with the disease hyperleucine-Isoleucinemia (OMIM:238340).